- Microcephaly (HP:0000252): Head circumference below 2 standard deviations below the mean for age and gender. Evidence: TAS. Frequency: Very frequent (HP:0040281). (ORPHA:85324)
- High forehead (HP:0000348): An abnormally increased height of the forehead. Evidence: TAS. Frequency: Very frequent (HP:0040281). (ORPHA:85324)
- Strabismus (HP:0000486): A misalignment of the eyes so that the visual axes deviate from bifoveal fixation. The classification of strabismus may be based on a number of features including the relative position of the eyes, whether the deviation is latent or manifest, intermittent or constant, concomitant or otherwise and according to the age of onset and the relevance of any associated refractive error. Evidence: TAS. Frequency: Very frequent (HP:0040281). (ORPHA:85324)
- Short stature (HP:0004322): A height below that which is expected according to age and gender norms. Although there is no universally accepted definition of short stature, many refer to "short stature" as height more than 2 standard deviations below the mean for age and gender (or below the 3rd percentile for age and gender dependent norms). Evidence: TAS. Frequency: Very frequent (HP:0040281). (ORPHA:85324)
- Severe intellectual disability (HP:0010864): Severe intellectual disability (ID) is defined as a type of ID characterized by severely sub-average adaptive functioning and intellectual functioning, with an intelligence quotient (IQ) the range of 20-34. Evidence: TAS. Frequency: Very frequent (HP:0040281). (ORPHA:85324)
These phenotypes are associated with the disease X-linked intellectual disability, Shrimpton type (ORPHA:85324).